- Abnormality of the immune system (HP:0002715): An abnormality of the immune system. Evidence: IEA. (OMIM:129150)
- Autosomal dominant inheritance (HP:0000006): A mode of inheritance that is observed for traits related to a gene encoded on one of the autosomes (i.e., the human chromosomes 1-22) in which a trait manifests in heterozygotes. In the context of medical genetics, an autosomal dominant disorder is caused when a single copy of the mutant allele is present. Males and females are affected equally, and can both transmit the disorder with a risk of 50% for each child of inheriting the mutant allele. Evidence: IEA. (OMIM:129150)
These phenotypes are associated with the disease Echo virus 11 sensitivity (OMIM:129150).